Phenotypes associated with the disease Orofaciodigital syndrome type 6 (ORPHA:2754):
- Cleft palate (HP:0000175): Cleft palate is a developmental defect of the palate resulting from a failure of fusion of the palatine processes and manifesting as a separation of the roof of the mouth (soft and hard palate). Evidence: TAS. Frequency: Frequent (HP:0040282). (ORPHA:2754)
- Lobulated tongue (HP:0000180): Multiple indentations and/or elevations on the edge and/or surface of the tongue producing an irregular surface contour. Evidence: TAS. Frequency: Frequent (HP:0040282). (ORPHA:2754)
- Abnormal oral frenulum morphology (HP:0000190): An abnormality of the lingual frenulum, that is of the small fold of mucous membrane that attaches the tongue to the floor of the mouth, or the presence of accessory frenula in the oral cavity. Evidence: TAS. Frequency: Frequent (HP:0040282). (ORPHA:2754)
- Tongue nodules (HP:0000199). Evidence: TAS. Frequency: Frequent (HP:0040282). (ORPHA:2754)
- High palate (HP:0000218): Height of the palate more than 2 SD above the mean (objective) or palatal height at the level of the first permanent molar more than twice the height of the teeth (subjective). Evidence: TAS. Frequency: Frequent (HP:0040282). (ORPHA:2754)
- Long face (HP:0000276): Facial height (length) is more than 2 standard deviations above the mean (objective); or, an apparent increase in the height (length) of the face (subjective). Evidence: TAS. Frequency: Frequent (HP:0040282). (ORPHA:2754)
- Epicanthus (HP:0000286): A fold of skin starting above the medial aspect of the upper eyelid and arching downward to cover, pass in front of and lateral to the medial canthus. Evidence: TAS. Frequency: Frequent (HP:0040282). (ORPHA:2754)
- Hypertelorism (HP:0000316): Interpupillary distance more than 2 SD above the mean (alternatively, the appearance of an increased interpupillary distance or widely spaced eyes). Evidence: TAS. Frequency: Frequent (HP:0040282). (ORPHA:2754)
- Micrognathia (HP:0000347): Developmental hypoplasia of the mandible. Evidence: TAS. Frequency: Frequent (HP:0040282). (ORPHA:2754)
- Conductive hearing impairment (HP:0000405): An abnormality of vibrational conductance of sound to the inner ear leading to impairment of sensory perception of sound. Evidence: TAS. Frequency: Frequent (HP:0040282). (ORPHA:2754)
- Broad nasal tip (HP:0000455): Increase in width of the nasal tip. Evidence: TAS. Frequency: Frequent (HP:0040282). (ORPHA:2754)
- Esotropia (HP:0000565): A form of strabismus with one or both eyes turned inward ('crossed') to a relatively severe degree, usually defined as 10 diopters or more. Evidence: TAS. Frequency: Frequent (HP:0040282). (ORPHA:2754)
- Nystagmus (HP:0000639): Rhythmic, involuntary oscillations of one or both eyes related to abnormality in fixation, conjugate gaze, or vestibular mechanisms. Evidence: TAS. Frequency: Frequent (HP:0040282). (ORPHA:2754)
- Brachydactyly (HP:0001156): Digits that appear disproportionately short compared to the hand/foot. The word brachydactyly is used here to describe a series distinct patterns of shortened digits (brachydactyly types A-E). This is the sense used here. Evidence: TAS. Frequency: Frequent (HP:0040282). (ORPHA:2754)
- Syndactyly (HP:0001159): Webbing or fusion of the fingers or toes, involving soft parts only or including bone structure. Bony fusions are referred to as "bony" syndactyly if the fusion occurs in a radio-ulnar axis. Fusions of bones of the fingers or toes in a proximo-distal axis are referred to as "symphalangism". Evidence: TAS. Frequency: Frequent (HP:0040282). (ORPHA:2754)
- Intellectual disability (HP:0001249): The term intellectual disability or intellectual developmental disorder is used to describe significantly sub-average intellectual and adaptive functioning based on clinical assessment and as measured by individually administered, appropriately normed, standardized and validated tests of intellectual functioning and adaptive behavior, with onset during the developmental period from infancy through adolescence. Evidence: TAS. Frequency: Frequent (HP:0040282). (ORPHA:2754)
- Ataxia (HP:0001251): Ataxia refers to impaired coordination of voluntary muscle movement. Cerebellar ataxia refers to ataxia due to dysfunction of the cerebellum. This causes a variety of elementary neurological deficits including asynergy (lack of coordination between muscles, limbs and joints), dysmetria (lack of ability to judge distances that can lead to under- or overshoot in grasping movements), and dysdiadochokinesia (inability to perform rapid movements requiring antagonizing muscle groups to be switched on and off repeatedly). Evidence: TAS. Frequency: Frequent (HP:0040282). (ORPHA:2754)
- Hypotonia (HP:0001252): Hypotonia is an abnormally low muscle tone (the amount of tension or resistance to movement in a muscle). Even when relaxed, muscles have a continuous and passive partial contraction which provides some resistance to passive stretching. Hypotonia thus manifests as diminished resistance to passive stretching. Hypotonia is not the same as muscle weakness, although the two conditions can co-exist. Evidence: TAS. Frequency: Frequent (HP:0040282). (ORPHA:2754)
- Global developmental delay (HP:0001263): A delay in the achievement of motor or mental milestones in the domains of development of a child, including motor skills, speech and language, cognitive skills, and social and emotional skills. This term should only be used to describe children younger than five years of age. Evidence: TAS. Frequency: Frequent (HP:0040282). (ORPHA:2754)
- Gait disturbance (HP:0001288): The term gait disturbance can refer to any disruption of the ability to walk. Evidence: TAS. Frequency: Frequent (HP:0040282). (ORPHA:2754)
- Generalized hypotonia (HP:0001290): Generalized muscular hypotonia (abnormally low muscle tone). Evidence: TAS. Frequency: Frequent (HP:0040282). (ORPHA:2754)
- Failure to thrive (HP:0001508): Failure to thrive (FTT) refers to a child whose physical growth is substantially below the norm. Evidence: TAS. Frequency: Frequent (HP:0040282). (ORPHA:2754)
- Growth delay (HP:0001510): A deficiency or slowing down of growth pre- and postnatally. Evidence: TAS. Frequency: Frequent (HP:0040282). (ORPHA:2754)
- Frontal bossing (HP:0002007): Bilateral bulging of the lateral frontal bone prominences with relative sparing of the midline. Evidence: TAS. Frequency: Frequent (HP:0040282). (ORPHA:2754)
- Molar tooth sign on MRI (HP:0002419): An abnormal appearance of the midbrain in axial magnetic resonance imaging in which the elongated superior cerebellar peduncles give the midbrain an appearance reminiscent of a molar or wisdom tooth. Evidence: TAS. Frequency: Frequent (HP:0040282). (ORPHA:2754)
- Short stature (HP:0004322): A height below that which is expected according to age and gender norms. Although there is no universally accepted definition of short stature, many refer to "short stature" as height more than 2 standard deviations below the mean for age and gender (or below the 3rd percentile for age and gender dependent norms). Evidence: TAS. Frequency: Frequent (HP:0040282). (ORPHA:2754)
- Biparietal narrowing (HP:0004422): A narrowing of the biparietal diameter (i.e., of the transverse distance between the protuberances of the two parietal bones of the skull). Evidence: TAS. Frequency: Frequent (HP:0040282). (ORPHA:2754)
- Hypoplasia of olfactory tract (HP:0007036). Evidence: TAS. Frequency: Frequent (HP:0040282). (ORPHA:2754)
- Bilateral cryptorchidism (HP:0008689): Absence of both testes from the scrotum owing to failure of the testis or testes to descend through the inguinal canal to the scrotum. Evidence: TAS. Frequency: Frequent (HP:0040282). (ORPHA:2754)
- Feeding difficulties in infancy (HP:0008872): Impaired feeding performance of an infant as manifested by difficulties such as weak and ineffective sucking, brief bursts of sucking, and falling asleep during sucking. There may be difficulties with chewing or maintaining attention. Evidence: TAS. Frequency: Frequent (HP:0040282). (ORPHA:2754)
- Hamartoma of tongue (HP:0011802): A benign (noncancerous) tumorlike malformation made up of an abnormal mixture of cells and tissues that originates in the tongue. Evidence: TAS. Frequency: Frequent (HP:0040282). (ORPHA:2754)
- Finger clinodactyly (HP:0040019). Evidence: TAS. Frequency: Frequent (HP:0040282). (ORPHA:2754)
- Preaxial polydactyly (HP:0100258): A form of polydactyly in which the extra digit or digits are localized on the side of the thumb or great toe. Evidence: TAS. Frequency: Frequent (HP:0040282). (ORPHA:2754)
- Renal agenesis (HP:0000104): Agenesis, that is, failure of the kidney to develop during embryogenesis and development. Evidence: TAS. Frequency: Occasional (HP:0040283). (ORPHA:2754)
- Prominent nasal bridge (HP:0000426): Anterior positioning of the nasal root in comparison to the usual positioning for age. Evidence: TAS. Frequency: Occasional (HP:0040283). (ORPHA:2754)
- Hand polydactyly (HP:0001161): A kind of polydactyly characterized by the presence of a supernumerary finger or fingers. Evidence: TAS. Frequency: Occasional (HP:0040283). (ORPHA:2754)
- Seizure (HP:0001250): A seizure is an intermittent abnormality of nervous system physiology characterized by a transient occurrence of signs and/or symptoms due to abnormal excessive or synchronous neuronal activity in the brain. Evidence: TAS. Frequency: Occasional (HP:0040283). (ORPHA:2754)
- Cerebellar vermis hypoplasia (HP:0001320): Underdevelopment of the vermis of cerebellum. Evidence: TAS. Frequency: Occasional (HP:0040283). (ORPHA:2754)
- Tremor (HP:0001337): An unintentional, oscillating to-and-fro muscle movement about a joint axis. Evidence: TAS. Frequency: Occasional (HP:0040283). (ORPHA:2754)
- Abnormal heart morphology (HP:0001627): Any structural anomaly of the heart. Evidence: TAS. Frequency: Occasional (HP:0040283). (ORPHA:2754)
- Foot polydactyly (HP:0001829): A kind of polydactyly characterized by the presence of a supernumerary toe or toes. Evidence: TAS. Frequency: Occasional (HP:0040283). (ORPHA:2754)
- Apnea (HP:0002104): Lack of breathing with no movement of the respiratory muscles and no exchange of air in the lungs. This term refers to a disposition to have recurrent episodes of apnea rather than to a single event. Evidence: TAS. Frequency: Occasional (HP:0040283). (ORPHA:2754)
- Abnormality of neuronal migration (HP:0002269): An abnormality resulting from an anomaly of neuronal migration, i.e., of the process by which neurons travel from their origin to their final position in the brain. Evidence: TAS. Frequency: Occasional (HP:0040283). (ORPHA:2754)
- Hypothalamic hamartoma (HP:0002444): The presence of a hamartoma of the hypothalamus. Evidence: TAS. Frequency: Occasional (HP:0040283). (ORPHA:2754)
- Highly arched eyebrow (HP:0002553): Increased height of the central portion of the eyebrow, forming a crescent, semicircular, or inverted U shape. Evidence: TAS. Frequency: Occasional (HP:0040283). (ORPHA:2754)
- Episodic tachypnea (HP:0002876): Episodes of very rapid breathing. Evidence: TAS. Frequency: Occasional (HP:0040283). (ORPHA:2754)
- Central Y-shaped metacarpal (HP:0006145): A central Y-shaped metacarpal is the result of a partial fusion of two central metacarpals (i.e., metacarpals 2-4) of the hand, with the two arms of the Y pointing in the distal direction. Central Y-shaped metacarpals may be seen as a result of a central polydactyly with partial fusion of the duplicated metacarpal. Evidence: TAS. Frequency: Occasional (HP:0040283). (ORPHA:2754)
- Aplasia/Hypoplasia of the corpus callosum (HP:0007370): Absence or underdevelopment of the corpus callosum. Evidence: TAS. Frequency: Occasional (HP:0040283). (ORPHA:2754)
- Renal hypoplasia/aplasia (HP:0008678): Absence or underdevelopment of the kidney. Evidence: TAS. Frequency: Occasional (HP:0040283). (ORPHA:2754)
- Midline notch of upper alveolar ridge (HP:0009084). Evidence: TAS. Frequency: Occasional (HP:0040283). (ORPHA:2754)
- Mesoaxial polydactyly (HP:0100260): The presence of a supernumerary finger or toe (not a thumb or hallux) involving the third or fourth metacarpal/tarsal with associated osseous syndactyly. Evidence: TAS. Frequency: Occasional (HP:0040283). (ORPHA:2754)
- Posteriorly rotated ears (HP:0000358): A type of abnormal location of the ears in which the position of the ears is characterized by posterior rotation (the superior part of the ears is rotated towards the back of the head, and the inferior part of the ears towards the front). Evidence: TAS. Frequency: Frequent (HP:0040282). (ORPHA:2754)